- Flat occiput (HP:0005469): Reduced convexity of the occiput (posterior part of skull). Evidence: PCS. Frequency: 3/3. (PMID:24501276)
- Bilateral tonic-clonic seizure (HP:0002069): A bilateral tonic-clonic seizure is a seizure defined by a tonic (bilateral increased tone, lasting seconds to minutes) and then a clonic (bilateral sustained rhythmic jerking) phase. Evidence: PCS. Frequency: 1/3. (PMID:24501276)
- Long philtrum (HP:0000343): Distance between nasal base and midline upper lip vermilion border more than 2 SD above the mean. Alternatively, an apparently increased distance between nasal base and midline upper lip vermilion border. Evidence: PCS. Frequency: 1/3. (PMID:24501276)
- Thin vermilion border (HP:0000233): Height of the vermilion of the medial part of the lip more than 2 SD below the mean, or apparently reduced height of the vermilion of the lip in the frontal view. The vermilion is the red part of the lips (and confusingly, the vermilion itself is also often referred to as being equivalent the lips). Evidence: PCS. Frequency: 3/3. (PMID:24501276)
- Mild intellectual disability (HP:0001256): Mild intellectual disability (ID) is defined as a type of ID characterized by mildly sub-average adaptive functioning and intellectual functioning, with an intelligence quotient (IQ) the range of 50-69. Evidence: PCS. Frequency: 4/4. (PMID:24626631)
- Anteverted nares (HP:0000463): Anteriorly-facing nostrils viewed with the head in the Frankfurt horizontal and the eyes of the observer level with the eyes of the subject. This gives the appearance of an upturned nose (upturned nasal tip). Evidence: PCS. Frequency: 3/3. (PMID:24501276)
- Bifid uvula (HP:0000193): Uvula separated into two parts most easily seen at the tip. Evidence: PCS. Frequency: 1/3. (PMID:24501276)
- Global developmental delay (HP:0001263): A delay in the achievement of motor or mental milestones in the domains of development of a child, including motor skills, speech and language, cognitive skills, and social and emotional skills. This term should only be used to describe children younger than five years of age. Evidence: PCS. (PMID:24501276)
- Hypotonia (HP:0001252): Hypotonia is an abnormally low muscle tone (the amount of tension or resistance to movement in a muscle). Even when relaxed, muscles have a continuous and passive partial contraction which provides some resistance to passive stretching. Hypotonia thus manifests as diminished resistance to passive stretching. Hypotonia is not the same as muscle weakness, although the two conditions can co-exist. Evidence: PCS. Frequency: 1/3. (PMID:24501276)
- Infantile onset (HP:0003593): Onset of signs or symptoms of disease between 28 days to one year of life. Evidence: TAS. (OMIM:615942)
- Depressed nasal bridge (HP:0005280): Posterior positioning of the nasal root in relation to the overall facial profile for age. Evidence: PCS. Frequency: 3/3. (PMID:24501276)
- Autosomal recessive inheritance (HP:0000007): A mode of inheritance that is observed for traits related to a gene encoded on one of the autosomes (i.e., the human chromosomes 1-22) in which a trait manifests in individuals with two pathogenic alleles, either homozygotes (two copies of the same mutant allele) or compound heterozygotes (whereby each copy of a gene has a distinct mutant allele). Evidence: PCS. (PMID:24501276)
- Pes planus (HP:0001763): A foot where the longitudinal arch of the foot is in contact with the ground or floor when the individual is standing; or, in a patient lying supine, a foot where the arch is in contact with the surface of a flat board pressed against the sole of the foot by the examiner with a pressure similar to that expected from weight bearing; or, the height of the arch is reduced. Evidence: PCS. Frequency: 4/4. (PMID:24626631)
- Focal-onset seizure (HP:0007359): A focal-onset seizure is a type of seizure originating within networks limited to one hemisphere. They may be discretely localized or more widely distributed, and may originate in subcortical structures. Evidence: PCS. Frequency: 1/3. (PMID:24501276)
- Intellectual disability (HP:0001249): The term intellectual disability or intellectual developmental disorder is used to describe significantly sub-average intellectual and adaptive functioning based on clinical assessment and as measured by individually administered, appropriately normed, standardized and validated tests of intellectual functioning and adaptive behavior, with onset during the developmental period from infancy through adolescence. Evidence: PCS. Frequency: 3/3. (PMID:24501276)
- Shawl scrotum (HP:0000049): Superior margin of the scrotum superior to the base of the penis. Evidence: PCS. Frequency: 1/2. (PMID:24501276)
These phenotypes are associated with the disease intellectual disability, autosomal recessive 44 (OMIM:615942).